Phenotypes associated with the disease hypohidrosis with abnormal palmar dermal Ridges (OMIM:241120):
- Abnormal palmar dermal ridges (HP:0007608). Evidence: IEA. (OMIM:241120)
- Autosomal recessive inheritance (HP:0000007): A mode of inheritance that is observed for traits related to a gene encoded on one of the autosomes (i.e., the human chromosomes 1-22) in which a trait manifests in individuals with two pathogenic alleles, either homozygotes (two copies of the same mutant allele) or compound heterozygotes (whereby each copy of a gene has a distinct mutant allele). Evidence: IEA. (OMIM:241120)
- Hypohidrosis (HP:0000966): Abnormally diminished capacity to sweat. Evidence: IEA. (OMIM:241120)
- Fever (HP:0001945): Body temperature elevated above the normal range. Evidence: TAS. (OMIM:241120)
- Decreased number of sweat glands (HP:0007500): The presence of fewer than normal sweat glands. Evidence: IEA. (OMIM:241120)